- Purpura (HP:0000979): Purpura (from Latin: purpura, meaning purple) is the appearance of red or purple discolorations on the skin that do not blanch on applying pressure. They are caused by bleeding underneath the skin. This term refers to an abnormally increased susceptibility to developing purpura. Purpura are larger than petechiae. Evidence: IEA. (OMIM:217000)
- Autosomal recessive inheritance (HP:0000007): A mode of inheritance that is observed for traits related to a gene encoded on one of the autosomes (i.e., the human chromosomes 1-22) in which a trait manifests in individuals with two pathogenic alleles, either homozygotes (two copies of the same mutant allele) or compound heterozygotes (whereby each copy of a gene has a distinct mutant allele). Evidence: IEA. (OMIM:217000)
- Systemic lupus erythematosus (HP:0002725): A chronic, relapsing, inflammatory, and often febrile multisystemic disorder of connective tissue, characterized principally by involvement of the skin, joints, kidneys, and serosal membranes. Evidence: IEA. (OMIM:217000)
These phenotypes are associated with the disease complement component 2 deficiency (OMIM:217000).